- Microdontia (HP:0000691): Decreased size of the teeth, which can be defined as a mesiodistal tooth diameter (width) more than 2 SD below mean. Alternatively, an apparently decreased maximum width of tooth. Evidence: TAS. Frequency: Very frequent (HP:0040281). (ORPHA:2722)
- Tooth malposition (HP:0000692): Abnormal alignment, positioning, or spacing of the teeth, i.e., misaligned teeth. Evidence: TAS. Frequency: Very frequent (HP:0040281). (ORPHA:2722)
- Palmoplantar keratoderma (HP:0000982): Abnormal thickening of the skin of the palms of the hands and the soles of the feet. Evidence: TAS. Frequency: Very frequent (HP:0040281). (ORPHA:2722)
- Abnormal fingernail morphology (HP:0001231): An abnormality of the fingernails. Evidence: TAS. Frequency: Very frequent (HP:0040281). (ORPHA:2722)
- Alopecia (HP:0001596): A noncongenital process of hair loss, which may progress to partial or complete baldness. Evidence: TAS. Frequency: Very frequent (HP:0040281). (ORPHA:2722)
- Hypoplastic toenails (HP:0001800): Underdevelopment of the toenail. Evidence: TAS. Frequency: Very frequent (HP:0040281). (ORPHA:2722)
- Sparse body hair (HP:0002231): Sparseness of the body hair. Evidence: TAS. Frequency: Very frequent (HP:0040281). (ORPHA:2722)
- Abnormal dental morphology (HP:0006482): An abnormality of the morphology of the tooth. Evidence: TAS. Frequency: Very frequent (HP:0040281). (ORPHA:2722)
- Sparse hair (HP:0008070): Reduced density of hairs. Evidence: TAS. Frequency: Very frequent (HP:0040281). (ORPHA:2722)
- Tooth agenesis (HP:0009804): The absence of one or more teeth from the normal series by a failure to develop. Evidence: TAS. Frequency: Very frequent (HP:0040281). (ORPHA:2722)
- Sparse eyebrow (HP:0045075): Decreased density/number of eyebrow hairs. Evidence: TAS. Frequency: Very frequent (HP:0040281). (ORPHA:2722)
These phenotypes are associated with the disease Odonto-onycho dysplasia-alopecia syndrome (ORPHA:2722).